- Lipoatrophy (HP:0100578): Localized loss of fat tissue. Evidence: TAS. Frequency: Obligate (HP:0040280). (ORPHA:90158)
- Reduced subcutaneous adipose tissue (HP:0003758): A reduced amount of fat tissue in the lowest layer of the integument. This feature can be appreciated by a reduced skinfold thickness. Evidence: TAS. Frequency: Very frequent (HP:0040281). (ORPHA:90158)
- Absence of subcutaneous fat (HP:0007485): Lack of subcutaneous adipose tissue. Evidence: TAS. Frequency: Frequent (HP:0040282). (ORPHA:90158)
- Hyperpigmentation of the skin (HP:0000953): A darkening of the skin related to an increase in melanin production and deposition. Evidence: TAS. Frequency: Occasional (HP:0040283). (ORPHA:90158)
- Pruritus (HP:0000989): Pruritus is an itch or a sensation that makes a person want to scratch. This term refers to an abnormally increased disposition to experience pruritus. Evidence: TAS. Frequency: Occasional (HP:0040283). (ORPHA:90158)
- Hypopigmentation of the skin (HP:0001010): A reduction of skin color related to a decrease in melanin production and deposition. Evidence: TAS. Frequency: Occasional (HP:0040283). (ORPHA:90158)
- Erythema (HP:0010783): Redness of the skin, caused by hyperemia of the capillaries in the lower layers of the skin. Evidence: TAS. Frequency: Occasional (HP:0040283). (ORPHA:90158)
- Inflammatory abnormality of the skin (HP:0011123): The presence of inflammation of the skin. That is, an abnormality of the skin resulting from the local accumulation of fluid, plasma proteins, and leukocytes. Evidence: TAS. Frequency: Occasional (HP:0040283). (ORPHA:90158)
- Morphea (HP:0012344): Isolated patches of hardened skin (scleroderma). Evidence: TAS. Frequency: Very rare (HP:0040284). (ORPHA:90158)
- Scaling skin (HP:0040189): Refers to the loss of the outer layer of the epidermis in large, scale-like flakes. Evidence: TAS. Frequency: Very rare (HP:0040284). (ORPHA:90158)
- Scleroderma (HP:0100324): A chronic autoimmune phenomenon characterized by fibrosis (or hardening) and vascular alterations of the skin. Evidence: TAS. Frequency: Very rare (HP:0040284). (ORPHA:90158)
These phenotypes are associated with the disease Idiopathic localized lipodystrophy (ORPHA:90158).